- Epiblepharon of upper lid (HP:0040150). Evidence: TAS. (OMIM:131460)
- Autosomal dominant inheritance (HP:0000006): A mode of inheritance that is observed for traits related to a gene encoded on one of the autosomes (i.e., the human chromosomes 1-22) in which a trait manifests in heterozygotes. In the context of medical genetics, an autosomal dominant disorder is caused when a single copy of the mutant allele is present. Males and females are affected equally, and can both transmit the disorder with a risk of 50% for each child of inheriting the mutant allele. Evidence: TAS. (OMIM:131460)
These phenotypes are associated with the disease EPIBLEPHARON OF UPPER LID (OMIM:131460).